Phenotypes associated with the disease Steroid dehydrogenase deficiency-dental anomalies syndrome (ORPHA:3196):
- Abnormal dental enamel morphology (HP:0000682): An abnormality of the dental enamel. Evidence: TAS. Frequency: Very frequent (HP:0040281). (ORPHA:3196)
- Hepatic failure (HP:0001399). Evidence: TAS. Frequency: Very frequent (HP:0040281). (ORPHA:3196)
- Enamel hypoplasia (HP:0006297): Developmental hypoplasia of the dental enamel. Evidence: TAS. Frequency: Very frequent (HP:0040281). (ORPHA:3196)
- Supernumerary tooth (HP:0011069): The presence of one or more teeth additional to the normal number. Evidence: TAS. Frequency: Very frequent (HP:0040281). (ORPHA:3196)